- Autosomal recessive inheritance (HP:0000007): A mode of inheritance that is observed for traits related to a gene encoded on one of the autosomes (i.e., the human chromosomes 1-22) in which a trait manifests in individuals with two pathogenic alleles, either homozygotes (two copies of the same mutant allele) or compound heterozygotes (whereby each copy of a gene has a distinct mutant allele). Evidence: PCS. (PMID:21063731)
- Intellectual disability (HP:0001249): The term intellectual disability or intellectual developmental disorder is used to describe significantly sub-average intellectual and adaptive functioning based on clinical assessment and as measured by individually administered, appropriately normed, standardized and validated tests of intellectual functioning and adaptive behavior, with onset during the developmental period from infancy through adolescence. Evidence: PCS. (PMID:21063731)
These phenotypes are associated with the disease intellectual disability, autosomal recessive 31 (OMIM:614329).